- Amelogenesis imperfecta (HP:0000705): A developmental dysplasia of the dental enamel. Evidence: TAS. Frequency: Very frequent (HP:0040281). (ORPHA:79129)
- Alopecia of scalp (HP:0002293). Evidence: TAS. Frequency: Very frequent (HP:0040281). (ORPHA:79129)
- Trichodysplasia (HP:0002552): Developmental dysplasia of the hair. Evidence: TAS. Frequency: Very frequent (HP:0040281). (ORPHA:79129)
These phenotypes are associated with the disease Trichodysplasia-amelogenesis imperfecta syndrome (ORPHA:79129).